- Hearing impairment (HP:0000365): A decreased magnitude of the sensory perception of sound. Evidence: PCS. (PMID:11163249)
- Sensorineural hearing impairment (HP:0000407): A type of hearing impairment in one or both ears related to an abnormal functionality of the cochlear nerve. Evidence: TAS. (OMIM:614035)
- Nonprogressive (HP:0003680): Applies to a disease manifestation that does not increase in scope or severity over the course of time, i.e., that does not worsen with age. Evidence: TAS. (OMIM:614035)
- Autosomal recessive inheritance (HP:0000007): A mode of inheritance that is observed for traits related to a gene encoded on one of the autosomes (i.e., the human chromosomes 1-22) in which a trait manifests in individuals with two pathogenic alleles, either homozygotes (two copies of the same mutant allele) or compound heterozygotes (whereby each copy of a gene has a distinct mutant allele). Evidence: PCS. (PMID:11163249)
These phenotypes are associated with the disease autosomal recessive nonsyndromic hearing loss 29 (OMIM:614035).